- Inverted nipples (HP:0003186): The presence of nipples that instead of pointing outward are retracted inwards. Evidence: IEA. (OMIM:163600)
- Autosomal dominant inheritance (HP:0000006): A mode of inheritance that is observed for traits related to a gene encoded on one of the autosomes (i.e., the human chromosomes 1-22) in which a trait manifests in heterozygotes. In the context of medical genetics, an autosomal dominant disorder is caused when a single copy of the mutant allele is present. Males and females are affected equally, and can both transmit the disorder with a risk of 50% for each child of inheriting the mutant allele. Evidence: IEA. (OMIM:163600)
These phenotypes are associated with the disease nipples inverted (OMIM:163600).